Phenotypes associated with the disease retinitis pigmentosa 31 (OMIM:609923):
- Visual field defect (HP:0001123). Evidence: PCS. Frequency: Frequent (HP:0040282). (PMID:17924349)
- Rod-cone dystrophy (HP:0000510): An inherited retinal disease subtype in which the rod photoreceptors appear to be more severely affected than the cone photoreceptors. Typical presentation is with nyctalopia (due to rod dysfunction) followed by loss of mid-peripheral field of vision, which gradually extends and leaves many patients with a small central island of vision due to the preservation of macular cones. Evidence: TAS. (OMIM:609923)
- Retinal pigment epithelial atrophy (HP:0007722): A nonspecific term denoting wasting, especially as a result of degeneration, of the retinal pigment epithelium (RPE). Evidence: PCS. (PMID:17924349)
- Attenuation of retinal blood vessels (HP:0007843): Narrowing of the retinal blood vessels, both arterioles and venules. Evidence: PCS. (PMID:17924349)
- Autosomal dominant inheritance (HP:0000006): A mode of inheritance that is observed for traits related to a gene encoded on one of the autosomes (i.e., the human chromosomes 1-22) in which a trait manifests in heterozygotes. In the context of medical genetics, an autosomal dominant disorder is caused when a single copy of the mutant allele is present. Males and females are affected equally, and can both transmit the disorder with a risk of 50% for each child of inheriting the mutant allele. Evidence: PCS. (PMID:17924349)
- Abnormal electroretinogram (HP:0000512): Any abnormality of the electrical responses of various cell types in the retina as measured by electroretinography. Evidence: PCS. Frequency: Frequent (HP:0040282). (PMID:17924349)